- Abnormality of the dentition (HP:0000164): Any abnormality of the teeth. Evidence: IEA. (OMIM:114700)
- Abnormality of molar (HP:0011077): An abnormality of molar tooth. Evidence: TAS. (PMID:14933364)
- Non-Mendelian inheritance (HP:0001426): A mode of inheritance that depends on genetic determinants in more than one gene. Evidence: TAS. (PMID:5079106)
- Shovel-shaped maxillary central incisors (HP:0006358): A tooth with a crown with marked lingual or palatal marginal ridges causing scooped lingual or palatal surfaces. Evidence: TAS. (PMID:5079106)
These phenotypes are associated with the disease Carabelli anomaly of maxillary molar teeth (OMIM:114700).